Phenotypes associated with the disease electroencephalographic peculiarity: fronto-precentral beta wave groups (OMIM:130300):
- EEG abnormality (HP:0002353): Abnormality observed by electroencephalogram (EEG), which is used to record of the brain's spontaneous electrical activity from multiple electrodes placed on the scalp. Evidence: IEA. (OMIM:130300)
- Autosomal dominant inheritance (HP:0000006): A mode of inheritance that is observed for traits related to a gene encoded on one of the autosomes (i.e., the human chromosomes 1-22) in which a trait manifests in heterozygotes. In the context of medical genetics, an autosomal dominant disorder is caused when a single copy of the mutant allele is present. Males and females are affected equally, and can both transmit the disorder with a risk of 50% for each child of inheriting the mutant allele. Evidence: IEA. (OMIM:130300)